- Juvenile onset (HP:0003621): Onset of signs or symptoms of disease between the age of 5 and 15 years. Evidence: PCS. Frequency: 2/7. (PMID:33268592)
- Bilateral sensorineural hearing impairment (HP:0008619): A form of sensorineural hearing impairment that affects both ears. Evidence: PCS. Frequency: 7/7. (PMID:33268592)
- Middle age onset (HP:0003596): A type of adult onset with onset of symptoms at the age of 40 to 60 years. Evidence: PCS. Frequency: 1/7. (PMID:33268592)
- Young adult onset (HP:0011462): Onset of disease at the age of between 16 and 40 years. Evidence: PCS. Frequency: 5/7. (PMID:33268592)
- Autosomal dominant inheritance (HP:0000006): A mode of inheritance that is observed for traits related to a gene encoded on one of the autosomes (i.e., the human chromosomes 1-22) in which a trait manifests in heterozygotes. In the context of medical genetics, an autosomal dominant disorder is caused when a single copy of the mutant allele is present. Males and females are affected equally, and can both transmit the disorder with a risk of 50% for each child of inheriting the mutant allele. Evidence: PCS. (PMID:33268592)
These phenotypes are associated with the disease hearing loss, autosomal dominant 83 (OMIM:619808).